Phenotypes associated with the disease autosomal recessive nonsyndromic hearing loss 49 (OMIM:610153):
- Congenital onset (HP:0003577): A phenotypic abnormality that is present at birth. Evidence: PCS. (PMID:17186462)
- Autosomal recessive inheritance (HP:0000007): A mode of inheritance that is observed for traits related to a gene encoded on one of the autosomes (i.e., the human chromosomes 1-22) in which a trait manifests in individuals with two pathogenic alleles, either homozygotes (two copies of the same mutant allele) or compound heterozygotes (whereby each copy of a gene has a distinct mutant allele). Evidence: PCS. (PMID:17186462)
- Prelingual sensorineural hearing impairment (HP:0000399): A form of sensorineural deafness with either congenital onset or infantile onset, i.e., before the acquisition of speech. Evidence: PCS. (PMID:17186462)